- Limb pain (HP:0009763): Chronic pain in the limbs with no clear focal etiology. Evidence: TAS. Frequency: Very frequent (HP:0040281). (ORPHA:83452)
- Dry skin (HP:0000958): Skin characterized by the lack of natural or normal moisture. Evidence: TAS. Frequency: Frequent (HP:0040282). (ORPHA:83452)
- Somatic sensory dysfunction (HP:0003474): An abnormality of the primary sensation that is mediated by peripheral nerves (pain, temperature, touch, vibration, joint position). The word hypoesthesia (or hypesthesia) refers to a reduction in cutaneous sensation to a specific type of testing. Evidence: TAS. Frequency: Frequent (HP:0040282). (ORPHA:83452)
- Involuntary movements (HP:0004305): Involuntary contractions of muscle leading to involuntary movements of extremities, neck, trunk, or face. Evidence: TAS. Frequency: Frequent (HP:0040282). (ORPHA:83452)
- Slow-growing nails (HP:0008383): Nails whose growth is slower than normal. Evidence: TAS. Frequency: Frequent (HP:0040282). (ORPHA:83452)
- Pedal edema (HP:0010741): An abnormal accumulation of excess fluid in the lower extremity resulting in swelling of the feet and extending upward to the lower leg. Evidence: TAS. Frequency: Frequent (HP:0040282). (ORPHA:83452)
- Edema of the upper limbs (HP:0010742): An abnormal accumulation of fluid beneath the skin of the arms. Evidence: TAS. Frequency: Frequent (HP:0040282). (ORPHA:83452)
- Erythema (HP:0010783): Redness of the skin, caused by hyperemia of the capillaries in the lower layers of the skin. Evidence: TAS. Frequency: Frequent (HP:0040282). (ORPHA:83452)
- Trophic changes related to pain (HP:0010834): Trophic changes is a term used to describe abnormalities in the area of pain that include primarily wasting away of the skin, tissues, or muscle, thinning of the bones, and changes in how the hair or nails grow, including thickening or thinning of hair or brittle nails. Evidence: TAS. Frequency: Frequent (HP:0040282). (ORPHA:83452)
- Allodynia (HP:0012533): Pain due to a stimulus that does not normally provoke pain. Evidence: TAS. Frequency: Frequent (HP:0040282). (ORPHA:83452)
- Dysesthesia (HP:0012534): Painful sensations elicited by a nonpainful cutaneous stimulus such as a light touch or gentle stroking over affected areas of the body. Sometimes referred to as hyperpathia or hyperalgesia. Often perceived as an intense burning, dyesthesias may outlast the stimulus by several seconds. Evidence: TAS. Frequency: Frequent (HP:0040282). (ORPHA:83452)
- Abnormality of hair growth (HP:0040170). Evidence: TAS. Frequency: Frequent (HP:0040282). (ORPHA:83452)
These phenotypes are associated with the disease Complex regional pain syndrome (ORPHA:83452).